Phenotypes associated with the disease cranial nerves, congenital paresis of (OMIM:218100):
- Facial palsy (HP:0010628): Facial nerve palsy is a dysfunction of cranial nerve VII (the facial nerve) that results in inability to control facial muscles on the affected side with weakness of the muscles of facial expression and eye closure. This can either be present in unilateral or bilateral form. Evidence: IEA. (OMIM:218100)
- Autosomal recessive inheritance (HP:0000007): A mode of inheritance that is observed for traits related to a gene encoded on one of the autosomes (i.e., the human chromosomes 1-22) in which a trait manifests in individuals with two pathogenic alleles, either homozygotes (two copies of the same mutant allele) or compound heterozygotes (whereby each copy of a gene has a distinct mutant allele). Evidence: IEA. (OMIM:218100)
- Abnormal pinna morphology (HP:0000377): An abnormality of the pinna, which is also referred to as the auricle or external ear. Evidence: IEA. (OMIM:218100)